Phenotypes associated with the disease intellectual disability, autosomal recessive 13 (OMIM:613192):
- Seizure (HP:0001250): A seizure is an intermittent abnormality of nervous system physiology characterized by a transient occurrence of signs and/or symptoms due to abnormal excessive or synchronous neuronal activity in the brain. Evidence: TAS. Frequency: Occasional (HP:0040283). (OMIM:613192)
- Infantile onset (HP:0003593): Onset of signs or symptoms of disease between 28 days to one year of life. Evidence: PCS. Frequency: 3/3. (PMID:20004764)
- Smooth philtrum (HP:0000319): Flat skin surface, with no ridge formation in the central region of the upper lip between the nasal base and upper vermilion border. Evidence: PCS. Frequency: 2/3. (PMID:20004764)
- Inferior cerebellar vermis hypoplasia (HP:0007068): Underdevelopment of the inferior portion of the vermis of cerebellum. Evidence: PCS. Frequency: 1/3. (PMID:20004763)
- Hypertelorism (HP:0000316): Interpupillary distance more than 2 SD above the mean (alternatively, the appearance of an increased interpupillary distance or widely spaced eyes). Evidence: PCS. Frequency: 1/3. (PMID:20004764)
- Downturned corners of mouth (HP:0002714): A morphological abnormality of the mouth in which the angle of the mouth is downturned. The oral commissures are positioned inferior to the midline labial fissure. Evidence: TAS. Frequency: Occasional (HP:0040283). (OMIM:613192)
- Hyperactivity (HP:0000752): Hyperactivity is a condition characterized by constant and unusually high levels of activity, even in situations where it is deemed inappropriate. Evidence: PCS. Frequency: 2/3. (PMID:20004764)
- Intellectual disability (HP:0001249): The term intellectual disability or intellectual developmental disorder is used to describe significantly sub-average intellectual and adaptive functioning based on clinical assessment and as measured by individually administered, appropriately normed, standardized and validated tests of intellectual functioning and adaptive behavior, with onset during the developmental period from infancy through adolescence. Evidence: PCS. Frequency: 3/3. (PMID:20004764)
- Bruxism (HP:0003763): Bruxism is characterized by the grinding of the teeth including the clenching of the jaw and typically occur during sleep. Evidence: PCS. Frequency: 1/3. (PMID:20004763)
- Wide nasal bridge (HP:0000431): Increased breadth of the nasal bridge (and with it, the nasal root). Evidence: TAS. Frequency: Occasional (HP:0040283). (OMIM:613192)
- Delayed speech and language development (HP:0000750): A degree of language development that is significantly below the norm for a child of a specified age. Evidence: PCS. Frequency: 4/6. (PMID:20004763;PMID:20004764)
- Hypoplasia of the corpus callosum (HP:0002079): Underdevelopment of the corpus callosum. Evidence: PCS. Frequency: 2/3. (PMID:20004763)
- Delayed ability to walk (HP:0031936): A failure to achieve the ability to walk at an appropriate developmental stage. Most children learn to walk in a series of stages, and learn to walk short distances independently between 12 and 15 months. Evidence: IEA. (OMIM:613192)
- Global developmental delay (HP:0001263): A delay in the achievement of motor or mental milestones in the domains of development of a child, including motor skills, speech and language, cognitive skills, and social and emotional skills. This term should only be used to describe children younger than five years of age. Evidence: PCS. Frequency: 1/3. (PMID:20004764)
- Short neck (HP:0000470): Diminished length of the neck. Evidence: PCS. Frequency: 2/3. (PMID:20004764)
- Secondary microcephaly (HP:0005484): Head circumference which falls below 2 standard deviations below the mean for age and gender because of insufficient head growth after birth. Evidence: TAS. Frequency: 3/3. (OMIM:613192)
- Mild microcephaly (HP:0040196): Decreased occipito-frontal (head) circumference (OFC). For the microcephaly OFC must be between -3 SD and -2 SD compared to appropriate, age matched, normal standards (i.e. -3 SD <= OFC < -2 SD). Evidence: PCS. Frequency: 1/3. (PMID:20004764)
- Recurrent hand flapping (HP:0100023): A type of repetitive behavior in which the affected individual repeatedly waves the hands and/or arms rhythmically. Evidence: PCS. Frequency: 1/3. (PMID:20004763)
- Hypotelorism (HP:0000601): Interpupillary distance less than 2 SD below the mean (alternatively, the appearance of an decreased interpupillary distance or closely spaced eyes). Evidence: PCS. Frequency: 1/3. (PMID:20004764)
- Autosomal recessive inheritance (HP:0000007): A mode of inheritance that is observed for traits related to a gene encoded on one of the autosomes (i.e., the human chromosomes 1-22) in which a trait manifests in individuals with two pathogenic alleles, either homozygotes (two copies of the same mutant allele) or compound heterozygotes (whereby each copy of a gene has a distinct mutant allele). Evidence: PCS. (PMID:20004763)
- Truncal obesity (HP:0001956): Obesity located preferentially in the trunk of the body as opposed to the extremities. Evidence: PCS. Frequency: 3/3. (PMID:20004764)
- Synophrys (HP:0000664): Meeting of the medial eyebrows in the midline. Evidence: TAS. Frequency: Occasional (HP:0040283). (OMIM:613192)
- Short philtrum (HP:0000322): Distance between nasal base and midline upper lip vermilion border more than 2 SD below the mean. Alternatively, an apparently decreased distance between nasal base and midline upper lip vermilion border. Evidence: PCS. Frequency: 2/3. (PMID:20004764)
- Slender finger (HP:0001238): Fingers that are disproportionately narrow (reduced girth) for the hand/foot size or build of the individual. Evidence: PCS. Frequency: 1/3. (PMID:20004764)
- Cleft upper lip (HP:0000204): A gap or groove in the upper lip. This is a congenital defect resulting from nonfusion of tissues of the lip during embryonal development. Evidence: PCS. Frequency: 1/3. (PMID:20004764)
- Abnormal cerebral white matter morphology (HP:0002500): An abnormality of the cerebral white matter. Evidence: PCS. Frequency: 1/3. (PMID:20004764)